- Esophageal obstruction (HP:0005240). Evidence: IEA. (OMIM:150700)
- Clitoral hypertrophy (HP:0008665): Hypertrophy of the clitoris. Evidence: IEA. (OMIM:150700)
- Autosomal dominant inheritance (HP:0000006): A mode of inheritance that is observed for traits related to a gene encoded on one of the autosomes (i.e., the human chromosomes 1-22) in which a trait manifests in heterozygotes. In the context of medical genetics, an autosomal dominant disorder is caused when a single copy of the mutant allele is present. Males and females are affected equally, and can both transmit the disorder with a risk of 50% for each child of inheriting the mutant allele. Evidence: IEA. (OMIM:150700)
These phenotypes are associated with the disease leiomyoma of vulva and esophagus (OMIM:150700).